- Hereditary nonpolyposis colorectal carcinoma (HP:0006716). Evidence: PCS. (PMID:9590282)
- Autosomal dominant inheritance (HP:0000006): A mode of inheritance that is observed for traits related to a gene encoded on one of the autosomes (i.e., the human chromosomes 1-22) in which a trait manifests in heterozygotes. In the context of medical genetics, an autosomal dominant disorder is caused when a single copy of the mutant allele is present. Males and females are affected equally, and can both transmit the disorder with a risk of 50% for each child of inheriting the mutant allele. Evidence: PCS. (PMID:9590282)
These phenotypes are associated with the disease colorectal cancer, hereditary nonpolyposis, type 6 (OMIM:614331).